Phenotypes associated with the disease lentigo (OMIM:150900):
- Nystagmus (HP:0000639): Rhythmic, involuntary oscillations of one or both eyes related to abnormality in fixation, conjugate gaze, or vestibular mechanisms. Evidence: IEA. (OMIM:150900)
- Autosomal dominant inheritance (HP:0000006): A mode of inheritance that is observed for traits related to a gene encoded on one of the autosomes (i.e., the human chromosomes 1-22) in which a trait manifests in heterozygotes. In the context of medical genetics, an autosomal dominant disorder is caused when a single copy of the mutant allele is present. Males and females are affected equally, and can both transmit the disorder with a risk of 50% for each child of inheriting the mutant allele. Evidence: IEA. (OMIM:150900)
- Abnormality of the skin (HP:0000951): An abnormality of the skin. Evidence: IEA. (OMIM:150900)